Phenotypes associated with the disease malocclusion due to protuberant upper front teeth (OMIM:154300):
- Dental malocclusion (HP:0000689): Dental malocclusion refers to an abnormality of the occlusion, or alignment, of the teeth and the way the upper and lower teeth fit together, resulting in overcrowding of teeth or in abnormal bite patterns. Evidence: IEA. (OMIM:154300)
- Autosomal dominant inheritance (HP:0000006): A mode of inheritance that is observed for traits related to a gene encoded on one of the autosomes (i.e., the human chromosomes 1-22) in which a trait manifests in heterozygotes. In the context of medical genetics, an autosomal dominant disorder is caused when a single copy of the mutant allele is present. Males and females are affected equally, and can both transmit the disorder with a risk of 50% for each child of inheriting the mutant allele. Evidence: IEA. (OMIM:154300)